Phenotypes associated with the disease nonsyndromic congenital nail disorder 4 (OMIM:206800):
- Growth abnormality (HP:0001507). Evidence: PCS. Frequency: 0/4. (PMID:17186469)
- Autosomal recessive inheritance (HP:0000007): A mode of inheritance that is observed for traits related to a gene encoded on one of the autosomes (i.e., the human chromosomes 1-22) in which a trait manifests in individuals with two pathogenic alleles, either homozygotes (two copies of the same mutant allele) or compound heterozygotes (whereby each copy of a gene has a distinct mutant allele). Evidence: PCS. (PMID:17186469)
- Anonychia (HP:0001798): Aplasia of the nail. Evidence: PCS. Frequency: 4/4. Onset: Congenital onset (HP:0003577). (PMID:17186469)